Phenotypes associated with the disease deafness, unilateral, with delayed endolymphatic hydrops (OMIM:612097):
- Edema (HP:0000969): An abnormal accumulation of fluid beneath the skin, or in one or more cavities of the body. Evidence: IEA. (OMIM:612097)
- Unilateral deafness (HP:0009900): A unilateral absence of sensory perception of sound. Evidence: IEA. (OMIM:612097)
- Autosomal dominant inheritance (HP:0000006): A mode of inheritance that is observed for traits related to a gene encoded on one of the autosomes (i.e., the human chromosomes 1-22) in which a trait manifests in heterozygotes. In the context of medical genetics, an autosomal dominant disorder is caused when a single copy of the mutant allele is present. Males and females are affected equally, and can both transmit the disorder with a risk of 50% for each child of inheriting the mutant allele. Evidence: IEA. (OMIM:612097)